- Fetal pericardial effusion (HP:0025671): An abnormal accumulation of fluid in which the heart is partially or completely surrounded by fluid that is seen in all views and the thickness of the fluid as observed by prenatal ultrasound is above age-dependent norms. Evidence: PCS. Frequency: 1/6. Onset: Fetal onset (HP:0011461). (PMID:25557780)
- Polyhydramnios (HP:0001561): The presence of excess amniotic fluid in the uterus during pregnancy. Evidence: TAS. (OMIM:219730)
- Seizure (HP:0001250): A seizure is an intermittent abnormality of nervous system physiology characterized by a transient occurrence of signs and/or symptoms due to abnormal excessive or synchronous neuronal activity in the brain. Evidence: PCS. Frequency: 1/1. (PMID:25557780)
- Renal insufficiency (HP:0000083): A reduction in the level of performance of the kidneys in areas of function comprising the concentration of urine, removal of wastes, the maintenance of electrolyte balance, homeostasis of blood pressure, and calcium metabolism. Evidence: TAS. (OMIM:219730)
- Gray matter heterotopia (HP:0002282): Heterotopia or neuronal heterotopia are macroscopic clusters of misplaced neurons (gray matter), most often situated along the ventricular walls or within the subcortical white matter. Evidence: PCS. Frequency: 1/6. (PMID:25557780)
- Elevated maternal circulating alpha-fetoprotein concentration (HP:0011432): Increase in the levels of maternal serum alpha-fetoprotein levels during pregnancy. Evidence: PCS. Frequency: 6/6. (PMID:25557780)
- Tubular luminal dilatation (HP:0032622): Dilatation (expansion beyond the normal dimension) of the cavity (lumen) of tubules of the kidney. The tubular cross section displays an attenuated brush border (apical PAS positivity greater than 10 percent of the normal expected height, but unequivocally less than normal expected height), resulting in an apparent increase in the size of lumen. Evidence: PCS. Frequency: 1/5. (PMID:25557780)
- Postaxial polydactyly (HP:0100259): A form of polydactyly in which the extra digit or digits are localized on the side of the fifth finger or fifth toe. Evidence: TAS. (OMIM:219730)
- Ventricular septal defect (HP:0001629): A hole between the two bottom chambers (ventricles) of the heart. The defect is centered around the most superior aspect of the ventricular septum. Evidence: PCS. Frequency: 1/6. (PMID:25557780)
- Fetal onset (HP:0011461): Onset prior to birth but after 8 weeks of embryonic development (corresponding to a gestational age of 10 weeks). Evidence: PCS. Frequency: 6/6. (PMID:25557780)
- Hyperechogenic kidneys (HP:0004719): An increase in amplitude of waves returned in ultrasonography of the kidney, which is generally displayed as increased brightness of the signal. Evidence: PCS. Frequency: 2/6. (PMID:25557780)
- Autosomal recessive inheritance (HP:0000007): A mode of inheritance that is observed for traits related to a gene encoded on one of the autosomes (i.e., the human chromosomes 1-22) in which a trait manifests in individuals with two pathogenic alleles, either homozygotes (two copies of the same mutant allele) or compound heterozygotes (whereby each copy of a gene has a distinct mutant allele). Evidence: PCS. (PMID:25557780)
- Hydrocephalus (HP:0000238): Hydrocephalus is an active distension of the ventricular system of the brain resulting from inadequate passage of CSF from its point of production within the cerebral ventricles to its point of absorption into the systemic circulation. Evidence: IEA. (OMIM:219730)
- Vascular dilatation (HP:0002617): An abnormal increase in the diameter of an artery or vein, either as a diffuse dilatation or as a localized, sac-like outpouching of the vessel wall (aneurysm). Evidence: IEA. (OMIM:219730)
- Ventriculomegaly (HP:0002119): An increase in size of the ventricular system of the brain. Evidence: PCS. Frequency: 4/6. (PMID:25557780)
- Renal corticomedullary cysts (HP:0000108): The presence of multiple cysts at the border between the renal cortex and medulla. Evidence: PCS. Frequency: 4/6. Onset: Fetal onset (HP:0011461). (PMID:25557780)
- Premature birth (HP:0001622): The birth of a baby of less than 37 weeks of gestational age. Evidence: TAS. Frequency: Occasional (HP:0040283). (OMIM:219730)
These phenotypes are associated with the disease ventriculomegaly-cystic kidney disease (OMIM:219730).